Phenotypes associated with the disease DERMATOGLYPHICS--HYPOTHENAR RADIAL ARCH (OMIM:221780):
- Autosomal recessive inheritance (HP:0000007): A mode of inheritance that is observed for traits related to a gene encoded on one of the autosomes (i.e., the human chromosomes 1-22) in which a trait manifests in individuals with two pathogenic alleles, either homozygotes (two copies of the same mutant allele) or compound heterozygotes (whereby each copy of a gene has a distinct mutant allele). Evidence: IEA. (OMIM:221780)
- Abnormal palmar dermatoglyphics (HP:0001018): An abnormality of the dermatoglyphs, i.e., an abnormality of the patterns of ridges of the skin of palm of hand. Evidence: IEA. (OMIM:221780)